- Focal impaired awareness seizure (HP:0002384): Focal impaired awareness seizure (or focal seizure with impaired or lost awareness) is a type of focal-onset seizure characterized by some degree (which may be partial) of impairment of the person's awareness of themselves or their surroundings at any point during the seizure. Evidence: PCS. Frequency: 8/11. (PMID:17377072)
- Bilateral tonic-clonic seizure with focal onset (HP:0007334): A bilateral tonic-clonic seizure with focal onset is a focal-onset seizure which progresses into a bilateral tonic-clonic phase. Evidence: PCS. Frequency: 4/11. (PMID:17377072)
- Deja vu aura (HP:0012005): A subjective feeling that an experience which is occurring for the first time has been experienced before. Evidence: PCS. Frequency: 10/11. (PMID:17377072)
- Autosomal dominant inheritance (HP:0000006): A mode of inheritance that is observed for traits related to a gene encoded on one of the autosomes (i.e., the human chromosomes 1-22) in which a trait manifests in heterozygotes. In the context of medical genetics, an autosomal dominant disorder is caused when a single copy of the mutant allele is present. Males and females are affected equally, and can both transmit the disorder with a risk of 50% for each child of inheriting the mutant allele. Evidence: PCS. (PMID:17377072)
These phenotypes are associated with the disease familial temporal lobe epilepsy 3 (OMIM:611630).